- Autoimmunity (HP:0002960): The occurrence of an immune reaction against the organism's own cells or tissues. Evidence: TAS. Frequency: Very frequent (HP:0040281). (ORPHA:46488)
- Abnormal blistering of the skin (HP:0008066): The presence of one or more bullae on the skin, defined as fluid-filled blisters more than 5 mm in diameter with thin walls. Evidence: TAS. Frequency: Very frequent (HP:0040281). (ORPHA:46488)
- Papule (HP:0200034): A circumscribed, solid elevation of skin with no visible fluid, varying in size from a pinhead to less than 10mm in diameter at the widest point. Evidence: TAS. Frequency: Very frequent (HP:0040281). (ORPHA:46488)
- Oral ulcer (HP:0000155): Erosion of the mucous mebrane of the mouth with local excavation of the surface, resulting from the sloughing of inflammatory necrotic tissue. Evidence: TAS. Frequency: Frequent (HP:0040282). (ORPHA:46488)
- Anti-LAD-1 antibody positivity (HP:4000027): The presence of autoantibodies (immunoglobulins) in the serum that react against LAD-1, which is the soluble 120 kDa ectodomain of BP180. Evidence: TAS. Frequency: Frequent (HP:0040282). (ORPHA:46488)
- Anti-LABD97 antibody positivity (HP:4000028): The presence of autoantibodies (immunoglobulins) in the serum that react against LABD97, which is structurally identical to a portion of the extracellular domain of BPAg2. BPAg2, a 180 kDa bullous pemphigoid antigen, is a transmembrane protein important for basement membrane cohesion. Evidence: TAS. Frequency: Frequent (HP:0040282). (ORPHA:46488)
- Epistaxis (HP:0000421): Epistaxis, or nosebleed, refers to a hemorrhage localized in the nose. Evidence: TAS. Frequency: Occasional (HP:0040283). (ORPHA:46488)
- Pruritus (HP:0000989): Pruritus is an itch or a sensation that makes a person want to scratch. This term refers to an abnormally increased disposition to experience pruritus. Evidence: TAS. Frequency: Occasional (HP:0040283). (ORPHA:46488)
- Inflammation of the large intestine (HP:0002037): Inflammation, or an inflammatory state in the large intestine. Evidence: TAS. Frequency: Occasional (HP:0040283). (ORPHA:46488)
- Bladder neoplasm (HP:0009725): The presence of a neoplasm of the urinary bladder. Evidence: TAS. Frequency: Occasional (HP:0040283). (ORPHA:46488)
- Renal neoplasm (HP:0009726): The presence of a neoplasm of the kidney. Evidence: TAS. Frequency: Occasional (HP:0040283). (ORPHA:46488)
These phenotypes are associated with the disease Linear IgA dermatosis (ORPHA:46488).